Phenotypes associated with the disease Atresia of urethra (ORPHA:105):
- Vesicoureteral reflux (HP:0000076): Abnormal (retrograde) movement of urine from the bladder into ureters or kidneys related to inadequacy of the valvular mechanism at the ureterovesicular junction or other causes. Evidence: TAS. Frequency: Very frequent (HP:0040281). (ORPHA:105)
- Renal insufficiency (HP:0000083): A reduction in the level of performance of the kidneys in areas of function comprising the concentration of urine, removal of wastes, the maintenance of electrolyte balance, homeostasis of blood pressure, and calcium metabolism. Evidence: TAS. Frequency: Very frequent (HP:0040281). (ORPHA:105)
- Recurrent urinary tract infections (HP:0000010): Repeated infections of the urinary tract. Evidence: TAS. Frequency: Frequent (HP:0040282). (ORPHA:105)
- Megacystis (HP:0000021): Dilatation of the bladder postnatally. Evidence: TAS. Frequency: Frequent (HP:0040282). (ORPHA:105)
- Hydroureter (HP:0000072): The distention of the ureter with urine. Evidence: TAS. Frequency: Frequent (HP:0040282). (ORPHA:105)
- Hydronephrosis (HP:0000126): Severe distention of the kidney with dilation of the renal pelvis and calices. Evidence: TAS. Frequency: Frequent (HP:0040282). (ORPHA:105)
- Oligohydramnios (HP:0001562): Diminished amniotic fluid volume in pregnancy. Evidence: TAS. Frequency: Frequent (HP:0040282). (ORPHA:105)
- Abdominal distention (HP:0003270): Distention of the abdomen. Evidence: TAS. Frequency: Frequent (HP:0040282). (ORPHA:105)
- Bladder fistula (HP:0004321): The presence of a fistula connecting the urinary bladder to another organ or the skin. The fistula can involve the bowel, the vagina, or rarely, the skin. Evidence: TAS. Frequency: Frequent (HP:0040282). (ORPHA:105)
- Patent urachus (HP:0010479): Persistence of the urachal canal resulting in a canal between the bladder and the umbilicus. Evidence: TAS. Frequency: Frequent (HP:0040282). (ORPHA:105)
- Dilatation of the bladder (HP:0010955): The presence of a dilated urinary bladder. Evidence: TAS. Frequency: Frequent (HP:0040282). (ORPHA:105)
- Renal dysplasia (HP:0000110): The presence of developmental dysplasia of the kidney. Evidence: TAS. Frequency: Occasional (HP:0040283). (ORPHA:105)
- Ascites (HP:0001541): Accumulation of fluid in the peritoneal cavity (between the layers of the peritoneum that lines the abdomen). Evidence: TAS. Frequency: Occasional (HP:0040283). (ORPHA:105)
- Pulmonic regurgitation (HP:0010444): The retrograde (backwards) flow of blood through the pulmonary valve into the right ventricle during diastole. Evidence: TAS. Frequency: Occasional (HP:0040283). (ORPHA:105)